- Dextrocardia (HP:0001651): The heart is located in the right hand sided hemithorax. That is, there is a left-right reversal (or "mirror reflection") of the anatomical location of the heart in which the heart is locate on the right side instead of the left. Evidence: TAS. Frequency: Obligate (HP:0040280). (ORPHA:1666)
- Abnormal heart morphology (HP:0001627): Any structural anomaly of the heart. Evidence: TAS. Frequency: Very frequent (HP:0040281). (ORPHA:1666)
- Abnormal EKG (HP:0003115): Abnormal rhythm of the heart. Evidence: TAS. Frequency: Very frequent (HP:0040281). (ORPHA:1666)
- T-wave inversion (HP:0010872): An inversion of the T-wave (which is normally positive). Evidence: TAS. Frequency: Very frequent (HP:0040281). (ORPHA:1666)
- Situs inversus totalis (HP:0001696): A left-right reversal (or mirror reflection) of the anatomical location of the major thoracic and abdominal organs. Evidence: TAS. Frequency: Frequent (HP:0040282). (ORPHA:1666)
- Congenital malformation of the great arteries (HP:0011603): Defect or defects of the morphogenesis of the aorta and pulmonary arteries. Evidence: TAS. Frequency: Frequent (HP:0040282). (ORPHA:1666)
- Abnormality of the ureter (HP:0000069): An abnormality of the ureter. The ureter is the duct by which urine passes from the kidney to the bladder. Evidence: TAS. Frequency: Occasional (HP:0040283). (ORPHA:1666)
- Abnormality of the spleen (HP:0001743): An abnormality of the spleen. Evidence: TAS. Frequency: Occasional (HP:0040283). (ORPHA:1666)
- Abnormal lung lobation (HP:0002101): A developmental defect in the formation of pulmonary lobes. Evidence: TAS. Frequency: Occasional (HP:0040283). (ORPHA:1666)
- Intestinal malrotation (HP:0002566): An abnormality of the intestinal rotation and fixation that normally occurs during the development of the gut. This can lead to volvulus, or twisting of the intestine that causes obstruction and necrosis. Evidence: TAS. Frequency: Occasional (HP:0040283). (ORPHA:1666)
- Abnormality of the pulmonary artery (HP:0004414): An abnormality of the pulmonary artery. Evidence: TAS. Frequency: Occasional (HP:0040283). (ORPHA:1666)
- Abnormal pulmonary situs morphology (HP:0011615): An abnormality of the pulmonary situs, i.e., of the sidedness of the morphological right and left lungs, which is defined by characteristics such as the number of lobes per lung and the relationship of the pulmonary arteries to their bronchi. Evidence: TAS. Frequency: Occasional (HP:0040283). (ORPHA:1666)
- Abnormality of abdominal situs (HP:0011620): An abnormality of the abdominal situs, i.e., of the sidedness of the abdomen and its organs. Evidence: TAS. Frequency: Occasional (HP:0040283). (ORPHA:1666)
- Abnormal renal morphology (HP:0012210): Any structural anomaly of the kidney. Evidence: TAS. Frequency: Occasional (HP:0040283). (ORPHA:1666)
- Abnormal reproductive system morphology (HP:0012243): A structural or developmental anomaly of any of the tissues involved in the genital system. Evidence: TAS. Frequency: Occasional (HP:0040283). (ORPHA:1666)
- Hydrocephalus (HP:0000238): Hydrocephalus is an active distension of the ventricular system of the brain resulting from inadequate passage of CSF from its point of production within the cerebral ventricles to its point of absorption into the systemic circulation. Evidence: TAS. Frequency: Very rare (HP:0040284). (ORPHA:1666)
- Preauricular skin tag (HP:0000384): A rudimentary tag of skin often containing ear tissue including a core of cartilage and located just anterior to the auricle (outer part of the ear). Evidence: TAS. Frequency: Very rare (HP:0040284). (ORPHA:1666)
- Webbed neck (HP:0000465): Pterygium colli is a congenital skin fold that runs along the sides of the neck down to the shoulders. It involves an ectopic fibrotic facial band superficial to the trapezius muscle. Excess hair-bearing skin is also present and extends down the cervical region well beyond the normal hairline. Evidence: TAS. Frequency: Very rare (HP:0040284). (ORPHA:1666)
- Abnormal rib morphology (HP:0000772): An anomaly of the rib. Evidence: TAS. Frequency: Very rare (HP:0040284). (ORPHA:1666)
- Global developmental delay (HP:0001263): A delay in the achievement of motor or mental milestones in the domains of development of a child, including motor skills, speech and language, cognitive skills, and social and emotional skills. This term should only be used to describe children younger than five years of age. Evidence: TAS. Frequency: Very rare (HP:0040284). (ORPHA:1666)
- Congenital hip dislocation (HP:0001374). Evidence: TAS. Frequency: Very rare (HP:0040284). (ORPHA:1666)
- Abnormal foot morphology (HP:0001760): An abnormality of the skeleton of foot. Evidence: TAS. Frequency: Very rare (HP:0040284). (ORPHA:1666)
- Meckel diverticulum (HP:0002245): Meckel's diverticulum is a congenital diverticulum located in the distal ileum. Evidence: TAS. Frequency: Very rare (HP:0040284). (ORPHA:1666)
- Pancreatic hypoplasia (HP:0002594): Hypoplasia of the pancreas. Evidence: TAS. Frequency: Very rare (HP:0040284). (ORPHA:1666)
- Neuroblastoma (HP:0003006): Neuroblastoma is a solid tumor that originate in neural crest cells of the sympathetic nervous system. Most neuroblastomas originate in the abdomen, and most abdominal neuroblastomas originate in the adrenal gland. Neuroblastomas can also originate in the thorax, usually in the posterior mediastinum. Evidence: TAS. Frequency: Very rare (HP:0040284). (ORPHA:1666)
- Aplasia/Hypoplasia of the ear (HP:0008771): The presence of aplasia or developmental hypoplasia of the ear. Evidence: TAS. Frequency: Very rare (HP:0040284). (ORPHA:1666)
These phenotypes are associated with the disease Dextrocardia (ORPHA:1666).